Phenotypes associated with the disease Neurodevelopmental delay-seizures-ophthalmic anomalies-osteopenia-cerebellar atrophy syndrome (ORPHA:529665):
- Seizure (HP:0001250): A seizure is an intermittent abnormality of nervous system physiology characterized by a transient occurrence of signs and/or symptoms due to abnormal excessive or synchronous neuronal activity in the brain. Evidence: TAS. Frequency: Very frequent (HP:0040281). (ORPHA:529665)
- EEG abnormality (HP:0002353): Abnormality observed by electroencephalogram (EEG), which is used to record of the brain's spontaneous electrical activity from multiple electrodes placed on the scalp. Evidence: TAS. Frequency: Very frequent (HP:0040281). (ORPHA:529665)
- Hypertelorism (HP:0000316): Interpupillary distance more than 2 SD above the mean (alternatively, the appearance of an increased interpupillary distance or widely spaced eyes). Evidence: TAS. Frequency: Frequent (HP:0040282). (ORPHA:529665)
- Narrow forehead (HP:0000341): Width of the forehead or distance between the frontotemporales is more than two standard deviations below the mean (objective); or apparently narrow intertemporal region (subjective). Evidence: TAS. Frequency: Frequent (HP:0040282). (ORPHA:529665)
- Broad nasal tip (HP:0000455): Increase in width of the nasal tip. Evidence: TAS. Frequency: Frequent (HP:0040282). (ORPHA:529665)
- Anteverted nares (HP:0000463): Anteriorly-facing nostrils viewed with the head in the Frankfurt horizontal and the eyes of the observer level with the eyes of the subject. This gives the appearance of an upturned nose (upturned nasal tip). Evidence: TAS. Frequency: Frequent (HP:0040282). (ORPHA:529665)
- Myopia (HP:0000545): An abnormality of refraction characterized by the ability to see objects nearby clearly, while objects in the distance appear blurry. Evidence: TAS. Frequency: Frequent (HP:0040282). (ORPHA:529665)
- Nystagmus (HP:0000639): Rhythmic, involuntary oscillations of one or both eyes related to abnormality in fixation, conjugate gaze, or vestibular mechanisms. Evidence: TAS. Frequency: Frequent (HP:0040282). (ORPHA:529665)
- Oculomotor apraxia (HP:0000657): Ocular motor apraxia is a deficiency in voluntary, horizontal, lateral, fast eye movements (saccades) with retention of slow pursuit movements. The inability to follow objects visually is often compensated by head movements. There may be decreased smooth pursuit, and cancelation of the vestibulo-ocular reflex. Evidence: TAS. Frequency: Frequent (HP:0040282). (ORPHA:529665)
- Delayed speech and language development (HP:0000750): A degree of language development that is significantly below the norm for a child of a specified age. Evidence: TAS. Frequency: Frequent (HP:0040282). (ORPHA:529665)
- Osteopenia (HP:0000938): Osteopenia is a term to define bone density that is not normal but also not as low as osteoporosis. By definition from the World Health Organization osteopenia is defined by bone densitometry as a T score -1 to -2.5. Evidence: TAS. Frequency: Frequent (HP:0040282). (ORPHA:529665)
- Osteoporosis (HP:0000939): Osteoporosis is a systemic skeletal disease characterized by low bone density and microarchitectural deterioration of bone tissue with a consequent increase in bone fragility. According to the WHO criteria, osteoporosis is defined as a BMD that lies 2.5 standard deviations or more below the average value for young healthy adults (a T-score below -2.5 SD). Evidence: TAS. Frequency: Frequent (HP:0040282). (ORPHA:529665)
- Mild intellectual disability (HP:0001256): Mild intellectual disability (ID) is defined as a type of ID characterized by mildly sub-average adaptive functioning and intellectual functioning, with an intelligence quotient (IQ) the range of 50-69. Evidence: TAS. Frequency: Frequent (HP:0040282). (ORPHA:529665)
- Spasticity (HP:0001257): A motor disorder characterized by a velocity-dependent increase in tonic stretch reflexes with increased muscle tone, exaggerated (hyperexcitable) tendon reflexes. Evidence: TAS. Frequency: Frequent (HP:0040282). (ORPHA:529665)
- Dysarthria (HP:0001260): Dysarthric speech is a general description referring to a neurological speech disorder characterized by poor articulation. Depending on the involved neurological structures, dysarthria may be further classified as spastic, flaccid, ataxic, hyperkinetic and hypokinetic, or mixed. Evidence: TAS. Frequency: Frequent (HP:0040282). (ORPHA:529665)
- Cerebellar atrophy (HP:0001272): Cerebellar atrophy is defined as a cerebellum with initially normal structures, in a posterior fossa with normal size, which displays enlarged fissures (interfolial spaces) in comparison to the foliae secondary to loss of tissue. Cerebellar atrophy implies irreversible loss of tissue and result from an ongoing progressive disease until a final stage is reached or a single injury, e.g. an intoxication or infectious event. Evidence: TAS. Frequency: Frequent (HP:0040282). (ORPHA:529665)
- Gait disturbance (HP:0001288): The term gait disturbance can refer to any disruption of the ability to walk. Evidence: TAS. Frequency: Frequent (HP:0040282). (ORPHA:529665)
- Generalized hypotonia (HP:0001290): Generalized muscular hypotonia (abnormally low muscle tone). Evidence: TAS. Frequency: Frequent (HP:0040282). (ORPHA:529665)
- Dysmetria (HP:0001310): A type of ataxia characterized by the inability to carry out movements with the correct range and motion across the plane of more than one joint related to incorrect estimation of the distances required for targeted movements. Evidence: TAS. Frequency: Frequent (HP:0040282). (ORPHA:529665)
- Cerebellar hypoplasia (HP:0001321): Cerebellar hypoplasia is a descriptive term implying a cerebellum with a reduced volume, but a normal shape and is stable over time. Evidence: TAS. Frequency: Frequent (HP:0040282). (ORPHA:529665)
- Tremor (HP:0001337): An unintentional, oscillating to-and-fro muscle movement about a joint axis. Evidence: TAS. Frequency: Frequent (HP:0040282). (ORPHA:529665)
- Hyperreflexia (HP:0001347): Hyperreflexia is the presence of hyperactive stretch reflexes of the muscles. Evidence: TAS. Frequency: Frequent (HP:0040282). (ORPHA:529665)
- Gait ataxia (HP:0002066): A type of ataxia characterized by the impairment of the ability to coordinate the movements required for normal walking. Gait ataxia is characteirzed by a wide-based staggering gait with a tendency to fall. Evidence: TAS. Frequency: Frequent (HP:0040282). (ORPHA:529665)
- Bilateral tonic-clonic seizure (HP:0002069): A bilateral tonic-clonic seizure is a seizure defined by a tonic (bilateral increased tone, lasting seconds to minutes) and then a clonic (bilateral sustained rhythmic jerking) phase. Evidence: TAS. Frequency: Frequent (HP:0040282). (ORPHA:529665)
- Difficulty standing (HP:0003698). Evidence: TAS. Frequency: Frequent (HP:0040282). (ORPHA:529665)
- Prominent forehead (HP:0011220): Forward prominence of the entire forehead, due to protrusion of the frontal bone. Evidence: TAS. Frequency: Frequent (HP:0040282). (ORPHA:529665)
- Neurodevelopmental delay (HP:0012758): Neurodevelopmental delay (NDD) refers to delays in the maturation of the brain and central nervous system; infants and young children with NDD may experience delays in the development of one or more skills including gross motor abilities, fine-motor coordination, language abilities and ability to solve increasingly complex problems. Evidence: TAS. Frequency: Frequent (HP:0040282). (ORPHA:529665)
- Visual impairment (HP:0000505): Visual impairment (or vision impairment) is vision loss (of a person) to such a degree as to qualify as an additional support need through a significant limitation of visual capability resulting from either disease, trauma, or congenital or degenerative conditions that cannot be corrected by conventional means, such as refractive correction, medication, or surgery. Evidence: TAS. Frequency: Very rare (HP:0040284). (ORPHA:529665)
- Optic atrophy (HP:0000648): Atrophy of the optic nerve. Optic atrophy results from the death of the retinal ganglion cell axons that comprise the optic nerve and manifesting as a pale optic nerve on fundoscopy. Evidence: TAS. Frequency: Very rare (HP:0040284). (ORPHA:529665)
- Status epilepticus (HP:0002133): Status epilepticus is a type of prolonged seizure resulting either from the failure of the mechanisms responsible for seizure termination or from the initiation of mechanisms which lead to abnormally prolonged seizures (after time point t1). It is a condition that can have long-term consequences (after time point t2), including neuronal death, neuronal injury, and alteration of neuronal networks, depending on the type and duration of seizures. Evidence: TAS. Frequency: Very rare (HP:0040284). (ORPHA:529665)
Not associated with this disease:
- Elevated circulating alkaline phosphatase concentration (HP:0003155): Abnormally increased serum levels of alkaline phosphatase activity. Evidence: TAS. (ORPHA:529665)